Phenotypes associated with the disease Ataxia-telangiectasia (ORPHA:100):
- Abnormal testis morphology (HP:0000035): An anomaly of the testicle (the male gonad). Evidence: TAS. Frequency: Occasional (HP:0040283). (ORPHA:100)
- Polycystic ovaries (HP:0000147). Evidence: TAS. Frequency: Very frequent (HP:0040281). (ORPHA:100)
- Strabismus (HP:0000486): A misalignment of the eyes so that the visual axes deviate from bifoveal fixation. The classification of strabismus may be based on a number of features including the relative position of the eyes, whether the deviation is latent or manifest, intermittent or constant, concomitant or otherwise and according to the age of onset and the relevance of any associated refractive error. Evidence: TAS. Frequency: Very frequent (HP:0040281). (ORPHA:100)
- Abnormality of eye movement (HP:0000496): An abnormality in voluntary or involuntary eye movements or their control. Evidence: TAS. Frequency: Very frequent (HP:0040281). (ORPHA:100)
- Nystagmus (HP:0000639): Rhythmic, involuntary oscillations of one or both eyes related to abnormality in fixation, conjugate gaze, or vestibular mechanisms. Evidence: TAS. Frequency: Very frequent (HP:0040281). (ORPHA:100)
- Diabetes mellitus (HP:0000819): A group of abnormalities characterized by hyperglycemia and glucose intolerance. Evidence: TAS. Frequency: Frequent (HP:0040282). (ORPHA:100)
- Delayed puberty (HP:0000823): Passing the age when puberty normally occurs with no physical or hormonal signs of the onset of puberty. Evidence: TAS. Frequency: Very frequent (HP:0040281). (ORPHA:100)
- Seizure (HP:0001250): A seizure is an intermittent abnormality of nervous system physiology characterized by a transient occurrence of signs and/or symptoms due to abnormal excessive or synchronous neuronal activity in the brain. Evidence: TAS. Frequency: Frequent (HP:0040282). (ORPHA:100)
- Ataxia (HP:0001251): Ataxia refers to impaired coordination of voluntary muscle movement. Cerebellar ataxia refers to ataxia due to dysfunction of the cerebellum. This causes a variety of elementary neurological deficits including asynergy (lack of coordination between muscles, limbs and joints), dysmetria (lack of ability to judge distances that can lead to under- or overshoot in grasping movements), and dysdiadochokinesia (inability to perform rapid movements requiring antagonizing muscle groups to be switched on and off repeatedly). Evidence: TAS. Frequency: Very frequent (HP:0040281). (ORPHA:100)
- Spasticity (HP:0001257): A motor disorder characterized by a velocity-dependent increase in tonic stretch reflexes with increased muscle tone, exaggerated (hyperexcitable) tendon reflexes. Evidence: TAS. Frequency: Frequent (HP:0040282). (ORPHA:100)
- Dysarthria (HP:0001260): Dysarthric speech is a general description referring to a neurological speech disorder characterized by poor articulation. Depending on the involved neurological structures, dysarthria may be further classified as spastic, flaccid, ataxic, hyperkinetic and hypokinetic, or mixed. Evidence: TAS. Frequency: Frequent (HP:0040282). (ORPHA:100)
- Gait disturbance (HP:0001288): The term gait disturbance can refer to any disruption of the ability to walk. Evidence: TAS. Frequency: Very frequent (HP:0040281). (ORPHA:100)
- Tremor (HP:0001337): An unintentional, oscillating to-and-fro muscle movement about a joint axis. Evidence: TAS. Frequency: Very frequent (HP:0040281). (ORPHA:100)
- Failure to thrive (HP:0001508): Failure to thrive (FTT) refers to a child whose physical growth is substantially below the norm. Evidence: TAS. Frequency: Occasional (HP:0040283). (ORPHA:100)
- Decreased total lymphocyte count (HP:0001888): A reduced number of lymphocytes in the blood. Evidence: TAS. Frequency: Very frequent (HP:0040281). (ORPHA:100)
- Abnormal speech pattern (HP:0002167): An abnormality in the sound (volume) or cadence (rate) of speech. Evidence: TAS. Frequency: Very frequent (HP:0040281). (ORPHA:100)
- Recurrent respiratory infections (HP:0002205): An increased susceptibility to respiratory infections as manifested by a history of recurrent respiratory infections. Evidence: TAS. Frequency: Very frequent (HP:0040281). (ORPHA:100)
- Premature graying of hair (HP:0002216): Development of gray hair at a younger than normal age. Evidence: TAS. Frequency: Very frequent (HP:0040281). (ORPHA:100)
- Neoplasm (HP:0002664): An organ or organ-system abnormality that consists of uncontrolled autonomous cell-proliferation which can occur in any part of the body as a benign or malignant neoplasm (tumor). Evidence: TAS. Frequency: Frequent (HP:0040282). (ORPHA:100)
- Abnormality of the immune system (HP:0002715): An abnormality of the immune system. Evidence: TAS. Frequency: Very frequent (HP:0040281). (ORPHA:100)
- Immunodeficiency (HP:0002721): Failure of the immune system to protect the body adequately from infection, due to the absence or insufficiency of some component process or substance. Evidence: TAS. Frequency: Very frequent (HP:0040281). (ORPHA:100)
- Elevated circulating hepatic transaminase concentration (HP:0002910): Elevations of the levels of SGOT and SGPT in the serum. SGOT (serum glutamic oxaloacetic transaminase) and SGPT (serum glutamic pyruvic transaminase) are transaminases primarily found in the liver and heart and are released into the bloodstream as the result of liver or heart damage. SGOT and SGPT are used clinically mainly as markers of liver damage. Evidence: TAS. Frequency: Very frequent (HP:0040281). (ORPHA:100)
- Skeletal muscle atrophy (HP:0003202): The presence of skeletal muscular atrophy (which is also known as amyotrophy). Evidence: TAS. Frequency: Frequent (HP:0040282). (ORPHA:100)
- Abnormality of chromosome stability (HP:0003220): A type of chromosomal aberration characterized by reduced resistance of chromosomes to change or deterioration. Evidence: TAS. Frequency: Very frequent (HP:0040281). (ORPHA:100)
- Decreased circulating immunoglobulin concentration (HP:0004313): An abnormally decreased level of immunoglobulin in blood. Evidence: TAS. Frequency: Very frequent (HP:0040281). (ORPHA:100)
- Short stature (HP:0004322): A height below that which is expected according to age and gender norms. Although there is no universally accepted definition of short stature, many refer to "short stature" as height more than 2 standard deviations below the mean for age and gender (or below the 3rd percentile for age and gender dependent norms). Evidence: TAS. Frequency: Frequent (HP:0040282). (ORPHA:100)
- Cellular immunodeficiency (HP:0005374): An immunodeficiency characterized by defective cell-mediated immunity or humoral immunity. Evidence: TAS. Frequency: Very frequent (HP:0040281). (ORPHA:100)
- Hypopigmentation of hair (HP:0005599). Evidence: TAS. Frequency: Frequent (HP:0040282). (ORPHA:100)
- Type II diabetes mellitus (HP:0005978): A type of diabetes mellitus initially characterized by insulin resistance and hyperinsulinemia and subsequently by glucose interolerance and hyperglycemia. Evidence: TAS. Frequency: Occasional (HP:0040283). (ORPHA:100)
- Prematurely aged appearance (HP:0007495). Evidence: TAS. Frequency: Very frequent (HP:0040281). (ORPHA:100)
- Multiple cafe-au-lait spots (HP:0007565): The presence of six or more cafe-au-lait spots. Evidence: TAS. Frequency: Occasional (HP:0040283). (ORPHA:100)
- Aplasia/Hypoplasia of the skin (HP:0008065). Evidence: TAS. Frequency: Occasional (HP:0040283). (ORPHA:100)
- Aplasia/Hypoplasia of the thymus (HP:0010515): Absence or underdevelopment of the thymus. Evidence: TAS. Frequency: Very frequent (HP:0040281). (ORPHA:100)
- Abnormality of movement (HP:0100022): An abnormality of movement with a neurological basis characterized by changes in coordination and speed of voluntary movements. Evidence: TAS. Frequency: Very frequent (HP:0040281). (ORPHA:100)
- Cognitive impairment (HP:0100543): Abnormal cognition is characterized by deficits in thinking, reasoning, or remembering. Evidence: TAS. Frequency: Occasional (HP:0040283). (ORPHA:100)
- Mucosal telangiectasiae (HP:0100579): Telangiectasia of the mucosa, the mucous membranes which are involved in absorption and secretion that line cavities that are exposed to the external environment and internal organs. Evidence: TAS. Frequency: Very frequent (HP:0040281). (ORPHA:100)
- Telangiectasia of the skin (HP:0100585): Presence of small, permanently dilated blood vessels near the surface of the skin, visible as small focal red lesions. Evidence: TAS. Frequency: Very frequent (HP:0040281). (ORPHA:100)